Phenotypes associated with the disease Neurogenic arthrogryposis multiplex congenita (ORPHA:1143):
- Flexion contracture (HP:0001371): A flexion contracture is a bent (flexed) joint that cannot be straightened actively or passively. It is thus a chronic loss of joint motion due to structural changes in muscle, tendons, ligaments, or skin that prevents normal movement of joints. Evidence: TAS. Frequency: Obligate (HP:0040280). (ORPHA:1143)
- EMG: chronic denervation signs (HP:0003444): Evidence of chronic denervation on electromyography. Evidence: TAS. Frequency: Very frequent (HP:0040281). (ORPHA:1143)
- Wrist flexion contracture (HP:0001239): A chronic loss of wrist joint motion due to structural changes in muscle, tendons, ligaments, or skin that prevent normal movement of the joints of the wrist. Evidence: TAS. Frequency: Frequent (HP:0040282). (ORPHA:1143)
- Areflexia (HP:0001284): Absence of neurologic reflexes such as the knee-jerk reaction. Evidence: TAS. Frequency: Frequent (HP:0040282). (ORPHA:1143)
- Elbow flexion contracture (HP:0002987): An elbow contracture that limits the ability of the elbow joint to be extended (straightened), meaning that the elbow is fixed in an flexed (bent) position. Evidence: TAS. Frequency: Frequent (HP:0040282). (ORPHA:1143)
- Skeletal muscle atrophy (HP:0003202): The presence of skeletal muscular atrophy (which is also known as amyotrophy). Evidence: TAS. Frequency: Frequent (HP:0040282). (ORPHA:1143)
- Upper limb muscle weakness (HP:0003484): Weakness of the muscles of the arms. Evidence: TAS. Frequency: Frequent (HP:0040282). (ORPHA:1143)
- Knee flexion contracture (HP:0006380): A type of knee joint contracture in which the knee is in a fixed bent (flexed) configuration such that it cannot be straightened actively or passively. Evidence: TAS. Frequency: Frequent (HP:0040282). (ORPHA:1143)
- Ankle flexion contracture (HP:0006466). Evidence: TAS. Frequency: Frequent (HP:0040282). (ORPHA:1143)
- Lower limb muscle weakness (HP:0007340): Weakness of the muscles of the legs. Evidence: TAS. Frequency: Frequent (HP:0040282). (ORPHA:1143)
- Mildly elevated creatine kinase (HP:0008180). Evidence: TAS. Frequency: Frequent (HP:0040282). (ORPHA:1143)
- Hypertelorism (HP:0000316): Interpupillary distance more than 2 SD above the mean (alternatively, the appearance of an increased interpupillary distance or widely spaced eyes). Evidence: TAS. Frequency: Occasional (HP:0040283). (ORPHA:1143)
- Micrognathia (HP:0000347): Developmental hypoplasia of the mandible. Evidence: TAS. Frequency: Occasional (HP:0040283). (ORPHA:1143)
- Plagiocephaly (HP:0001357): Asymmetric head shape, which is usually a combination of unilateral occipital flattening with ipsilateral frontal prominence, leading to rhomboid cranial shape. Evidence: TAS. Frequency: Occasional (HP:0040283). (ORPHA:1143)
- Decreased fetal movement (HP:0001558): An abnormal reduction in quantity or strength of fetal movements. Evidence: TAS. Frequency: Occasional (HP:0040283). (ORPHA:1143)
- Oligohydramnios (HP:0001562): Diminished amniotic fluid volume in pregnancy. Evidence: TAS. Frequency: Occasional (HP:0040283). (ORPHA:1143)
- Breech presentation (HP:0001623): A position of the fetus at delivery in which the fetus enters the birth canal with the buttocks or feet first. Evidence: TAS. Frequency: Occasional (HP:0040283). (ORPHA:1143)
- Abnormal heart morphology (HP:0001627): Any structural anomaly of the heart. Evidence: TAS. Frequency: Occasional (HP:0040283). (ORPHA:1143)
- Rocker bottom foot (HP:0001838): The presence of both a prominent heel and a convex contour of the sole. Evidence: TAS. Frequency: Occasional (HP:0040283). (ORPHA:1143)
- Myopathic facies (HP:0002058): A facial appearance characteristic of myopathic conditions. The face appears expressionless with sunken cheeks, bilateral ptosis, and inability to elevate the corners of the mouth, due to muscle weakness. Evidence: TAS. Frequency: Occasional (HP:0040283). (ORPHA:1143)
- Respiratory distress (HP:0002098): Respiratory distress is objectively observable as the physical or emotional consequences from the experience of dyspnea. The physical presentation of respiratory distress is generally referred to as labored breathing, while the sensation of respiratory distress is called shortness of breath or dyspnea. Evidence: TAS. Frequency: Occasional (HP:0040283). (ORPHA:1143)
- Fasciculations (HP:0002380): Fasciculations are observed as small, local, involuntary muscle contractions (twitching) visible under the skin. Fasciculations result from increased irritability of an axon (which in turn is often a manifestation of disease of a motor neuron). This leads to sporadic discharges of all the muscle fibers controlled by the axon in isolation from other motor units. Evidence: TAS. Frequency: Occasional (HP:0040283). (ORPHA:1143)
- Scoliosis (HP:0002650): The presence of an abnormal lateral curvature of the spine. Evidence: TAS. Frequency: Occasional (HP:0040283). (ORPHA:1143)
- Respiratory insufficiency due to muscle weakness (HP:0002747). Evidence: TAS. Frequency: Occasional (HP:0040283). (ORPHA:1143)
- Hip dislocation (HP:0002827): Displacement of the femur from its normal location in the hip joint. Evidence: TAS. Frequency: Occasional (HP:0040283). (ORPHA:1143)
- Hip contracture (HP:0003273): Lack of full passive range of motion (restrictions in flexion, extension, or other movements) of the hip joint resulting from structural changes of non-bony tissues, such as muscles, tendons, ligaments, joint capsules and/or skin. Evidence: TAS. Frequency: Occasional (HP:0040283). (ORPHA:1143)
- Abnormal dermatoglyphics (HP:0007477): An abnormality of dermatoglyphs (fingerprints), which are present on fingers, palms, toes, and soles. Evidence: TAS. Frequency: Occasional (HP:0040283). (ORPHA:1143)
- Equinovarus deformity (HP:0008110). Evidence: TAS. Frequency: Occasional (HP:0040283). (ORPHA:1143)
- Acetabular dysplasia (HP:0008807): A smaller than normal acetabulum that has insufficient femoral head coverage leading to abnormal hip joint contact pressures, instability and pain. Evidence: TAS. Frequency: Occasional (HP:0040283). (ORPHA:1143)
- Skin dimple (HP:0010781): Skin dimples are cutaneous indentations that are the result of tethering of the skin to underlying structures (bone) causing an indentation. Evidence: TAS. Frequency: Occasional (HP:0040283). (ORPHA:1143)
- Feeding difficulties (HP:0011968): Impaired ability to eat related to problems gathering food and getting ready to suck, chew, or swallow it. Evidence: TAS. Frequency: Occasional (HP:0040283). (ORPHA:1143)
- Scaphocephaly (HP:0030799): Scaphocephaly is a subtype of dolichocephaly where the anterior and posterior aspects of the cranial vault are pointed (boat-shaped). Scaphocephaly is caused by a precocious fusion of sagittal suture without other associated synostosis. Evidence: TAS. Frequency: Occasional (HP:0040283). (ORPHA:1143)
- Brain imaging abnormality (HP:0410263): An anomaly of metabolism or structure of the brain identified by imaging. Evidence: TAS. Frequency: Occasional (HP:0040283). (ORPHA:1143)